- Abnormality of the genitourinary system (HP:0000119): The presence of any abnormality of the genitourinary system. Evidence: IEA. (OMIM:149600)
- Autosomal dominant inheritance (HP:0000006): A mode of inheritance that is observed for traits related to a gene encoded on one of the autosomes (i.e., the human chromosomes 1-22) in which a trait manifests in heterozygotes. In the context of medical genetics, an autosomal dominant disorder is caused when a single copy of the mutant allele is present. Males and females are affected equally, and can both transmit the disorder with a risk of 50% for each child of inheriting the mutant allele. Evidence: IEA. (OMIM:149600)
These phenotypes are associated with the disease labia minora, incomplete adhesion of (OMIM:149600).